Phenotypes associated with the disease Autosomal recessive spastic paraplegia type 20 (ORPHA:101000):
- Hypertelorism (HP:0000316): Interpupillary distance more than 2 SD above the mean (alternatively, the appearance of an increased interpupillary distance or widely spaced eyes). Evidence: TAS. Frequency: Frequent (HP:0040282). (ORPHA:101000)
- Delayed speech and language development (HP:0000750): A degree of language development that is significantly below the norm for a child of a specified age. Evidence: TAS. Frequency: Frequent (HP:0040282). (ORPHA:101000)
- Abnormality of the skeletal system (HP:0000924): An abnormality of the skeletal system. Evidence: TAS. Frequency: Frequent (HP:0040282). (ORPHA:101000)
- Abnormality of the hand (HP:0001155): An abnormality affecting one or both hands. Evidence: TAS. Frequency: Frequent (HP:0040282). (ORPHA:101000)
- Spasticity (HP:0001257): A motor disorder characterized by a velocity-dependent increase in tonic stretch reflexes with increased muscle tone, exaggerated (hyperexcitable) tendon reflexes. Evidence: TAS. Frequency: Frequent (HP:0040282). (ORPHA:101000)
- Dysarthria (HP:0001260): Dysarthric speech is a general description referring to a neurological speech disorder characterized by poor articulation. Depending on the involved neurological structures, dysarthria may be further classified as spastic, flaccid, ataxic, hyperkinetic and hypokinetic, or mixed. Evidence: TAS. Frequency: Frequent (HP:0040282). (ORPHA:101000)
- Global developmental delay (HP:0001263): A delay in the achievement of motor or mental milestones in the domains of development of a child, including motor skills, speech and language, cognitive skills, and social and emotional skills. This term should only be used to describe children younger than five years of age. Evidence: TAS. Frequency: Frequent (HP:0040282). (ORPHA:101000)
- Motor delay (HP:0001270): A type of Developmental delay characterized by a delay in acquiring motor skills. Evidence: TAS. Frequency: Frequent (HP:0040282). (ORPHA:101000)
- Generalized hypotonia (HP:0001290): Generalized muscular hypotonia (abnormally low muscle tone). Evidence: TAS. Frequency: Frequent (HP:0040282). (ORPHA:101000)
- Abnormal cerebellum morphology (HP:0001317): Any structural abnormality of the cerebellum. Evidence: TAS. Frequency: Frequent (HP:0040282). (ORPHA:101000)
- Specific learning disability (HP:0001328): Impairment of certain skills such as reading or writing, coordination, self-control, or attention that interfere with the ability to learn. The impairment is not related to a global deficiency of intelligence. Evidence: TAS. Frequency: Frequent (HP:0040282). (ORPHA:101000)
- Hyperreflexia (HP:0001347): Hyperreflexia is the presence of hyperactive stretch reflexes of the muscles. Evidence: TAS. Frequency: Frequent (HP:0040282). (ORPHA:101000)
- Slurred speech (HP:0001350): Abnormal coordination of muscles involved in speech. Evidence: TAS. Frequency: Frequent (HP:0040282). (ORPHA:101000)
- Joint hypermobility (HP:0001382): The capability that a joint (or a group of joints) has to move, passively and/or actively, beyond normal limits along physiological axes. Evidence: TAS. Frequency: Frequent (HP:0040282). (ORPHA:101000)
- Growth delay (HP:0001510): A deficiency or slowing down of growth pre- and postnatally. Evidence: TAS. Frequency: Frequent (HP:0040282). (ORPHA:101000)
- Abnormal foot morphology (HP:0001760): An abnormality of the skeleton of foot. Evidence: TAS. Frequency: Frequent (HP:0040282). (ORPHA:101000)
- Dysphagia (HP:0002015): Difficulty in swallowing. Evidence: TAS. Frequency: Frequent (HP:0040282). (ORPHA:101000)
- Constipation (HP:0002019): Infrequent or difficult evacuation of feces. Evidence: TAS. Frequency: Frequent (HP:0040282). (ORPHA:101000)
- Spastic paraparesis (HP:0002313): Partial loss of the ability to move the lower limbs accompanied by spasticity of the lower limbs. Evidence: TAS. Frequency: Frequent (HP:0040282). (ORPHA:101000)
- Spastic dysarthria (HP:0002464): A type of dysarthria related to bilateral damage of the upper motor neuron tracts of the pyramidal and extra- pyramidal tracts. Speech of affected individuals is slow, effortful, and has a harsh vocal quality. Evidence: TAS. Frequency: Frequent (HP:0040282). (ORPHA:101000)
- Impaired vibratory sensation (HP:0002495): A decrease in the ability to perceive vibration. Clinically, this is usually tested with a tuning fork which vibrates at 128 Hz and is applied to bony prominences such as the malleoli at the ankles or the metacarpal-phalangeal joints. There is a slow decay of vibration from the tuning fork. The degree of vibratory sense loss can be crudely estimated by counting the number of seconds that the examiner can perceive the vibration longer than the patient. Evidence: TAS. Frequency: Frequent (HP:0040282). (ORPHA:101000)
- Skeletal muscle atrophy (HP:0003202): The presence of skeletal muscular atrophy (which is also known as amyotrophy). Evidence: TAS. Frequency: Frequent (HP:0040282). (ORPHA:101000)
- Upper limb muscle weakness (HP:0003484): Weakness of the muscles of the arms. Evidence: TAS. Frequency: Frequent (HP:0040282). (ORPHA:101000)
- Babinski sign (HP:0003487): Upturning of the big toe (and sometimes fanning of the other toes) in response to stimulation of the sole of the foot. If the Babinski sign is present it can indicate damage to the corticospinal tract. Evidence: TAS. Frequency: Frequent (HP:0040282). (ORPHA:101000)
- Short stature (HP:0004322): A height below that which is expected according to age and gender norms. Although there is no universally accepted definition of short stature, many refer to "short stature" as height more than 2 standard deviations below the mean for age and gender (or below the 3rd percentile for age and gender dependent norms). Evidence: TAS. Frequency: Frequent (HP:0040282). (ORPHA:101000)
- Abnormal hand morphology (HP:0005922): Any structural anomaly of the hand. Evidence: TAS. Frequency: Frequent (HP:0040282). (ORPHA:101000)
- Increased overbite (HP:0011094): Maxillary teeth cover the mandibular teeth when biting to an increased degree. The feature is defined as a vertical overlap of the maxillary incisors over the mandibular incisors that exceeds 2 mm. Evidence: TAS. Frequency: Frequent (HP:0040282). (ORPHA:101000)
- Abnormal brain morphology (HP:0012443): A structural abnormality of the brain, which has as its parts the forebrain, midbrain, and hindbrain. Evidence: TAS. Frequency: Frequent (HP:0040282). (ORPHA:101000)
- Dysuria (HP:0100518): Painful or difficult urination. Evidence: TAS. Frequency: Frequent (HP:0040282). (ORPHA:101000)
- Cognitive impairment (HP:0100543): Abnormal cognition is characterized by deficits in thinking, reasoning, or remembering. Evidence: TAS. Frequency: Frequent (HP:0040282). (ORPHA:101000)
- Microcephaly (HP:0000252): Head circumference below 2 standard deviations below the mean for age and gender. Evidence: TAS. Frequency: Occasional (HP:0040283). (ORPHA:101000)
- Epicanthus (HP:0000286): A fold of skin starting above the medial aspect of the upper eyelid and arching downward to cover, pass in front of and lateral to the medial canthus. Evidence: TAS. Frequency: Occasional (HP:0040283). (ORPHA:101000)
- Low-set ears (HP:0000369): Upper insertion of the ear to the scalp below an imaginary horizontal line drawn between the inner canthi of the eye and extending posteriorly to the ear. Evidence: TAS. Frequency: Occasional (HP:0040283). (ORPHA:101000)
- Prominent nose (HP:0000448): Distance between subnasale and pronasale more than two standard deviations above the mean, or alternatively, an apparently increased anterior protrusion of the nasal tip. Evidence: TAS. Frequency: Occasional (HP:0040283). (ORPHA:101000)
- Downslanted palpebral fissures (HP:0000494): The palpebral fissure inclination is more than two standard deviations below the mean. Evidence: TAS. Frequency: Occasional (HP:0040283). (ORPHA:101000)
- Psychosis (HP:0000709): A condition characterized by changes in personality and thought patterns, often accompanied by hallucinations and delusional beliefs, is known as psychosis. Evidence: TAS. Frequency: Occasional (HP:0040283). (ORPHA:101000)
- Emotional lability (HP:0000712): Unstable emotional experiences and frequent mood changes; emotions that are easily aroused, intense, and/or disproportionate to events and circumstances. Evidence: TAS. Frequency: Occasional (HP:0040283). (ORPHA:101000)
- Hallucinations (HP:0000738): Perceptions in a conscious and awake state that, in the absence of external stimuli, have qualities of real perception. These perceptions are vivid, substantial, and located in external objective space. Evidence: TAS. Frequency: Occasional (HP:0040283). (ORPHA:101000)
- Anxiety (HP:0000739): Intense feelings of nervousness, tension, or panic often arise in response to interpersonal stresses. There is worry about the negative effects of past unpleasant experiences and future negative possibilities. Individuals may feel fearful, apprehensive, or threatened by uncertainty, and they may also have fears of falling apart or losing control. Evidence: TAS. Frequency: Occasional (HP:0040283). (ORPHA:101000)
- Abnormal thumb morphology (HP:0001172): An abnormal structure of the first digit of the hand. Evidence: TAS. Frequency: Occasional (HP:0040283). (ORPHA:101000)
- Hoarse voice (HP:0001609): Hoarseness refers to a change in the pitch or quality of the voice, with the voice sounding weak, very breathy, scratchy, or husky. Evidence: TAS. Frequency: Occasional (HP:0040283). (ORPHA:101000)
- Pes cavus (HP:0001761): An increase in height of the medial longitudinal arch of the foot that does not flatten on weight bearing (i.e., a distinctly hollow form of the sole of the foot when it is bearing weight). Evidence: TAS. Frequency: Occasional (HP:0040283). (ORPHA:101000)
- Spastic gait (HP:0002064): Spasticity is manifested by increased stretch reflex which is intensified with movement velocity. This results in excessive and inappropriate muscle activation which can contribute to muscle hypertonia. Spastic gait is characterized by manifestations such as muscle hypertonia, stiff knee, and circumduction of the leg. Evidence: TAS. Frequency: Occasional (HP:0040283). (ORPHA:101000)
- Sleep disturbance (HP:0002360): An abnormal pattern in the quality, quantity, or characteristics of sleep. Evidence: TAS. Frequency: Occasional (HP:0040283). (ORPHA:101000)
- Genu valgum (HP:0002857): The legs angle inward, such that the knees are close together and the ankles far apart. Evidence: TAS. Frequency: Occasional (HP:0040283). (ORPHA:101000)
- Distal amyotrophy (HP:0003693): Muscular atrophy affecting muscles in the distal portions of the extremities. Evidence: TAS. Frequency: Occasional (HP:0040283). (ORPHA:101000)
- Abnormal nostril morphology (HP:0005288): Abnormality of the nostril. Evidence: TAS. Frequency: Occasional (HP:0040283). (ORPHA:101000)
- Speech apraxia (HP:0011098): A type of apraxia that is characterized by difficulty or inability to execute speech movements because of problems with coordination and motor problems, leading to incorrect articulation. An increase of errors with increasing word and phrase length may occur. Evidence: TAS. Frequency: Occasional (HP:0040283). (ORPHA:101000)
- Ankle clonus (HP:0011448): Clonus is an involuntary tendon reflex that causes repeated flexion and extension of the foot. Ankle clonus is tested by rapidly flexing the foot upward. Evidence: TAS. Frequency: Occasional (HP:0040283). (ORPHA:101000)
- Panic attack (HP:0025269): A sudden episode of intense fear in a situation where there is no danger or apparent cause. Evidence: TAS. Frequency: Occasional (HP:0040283). (ORPHA:101000)
- Clinodactyly (HP:0030084): An angulation of a digit at an interphalangeal joint in the plane of the palm (finger) or sole (toe). Evidence: TAS. Frequency: Occasional (HP:0040283). (ORPHA:101000)
- Hydronephrosis (HP:0000126): Severe distention of the kidney with dilation of the renal pelvis and calices. Evidence: TAS. Frequency: Very rare (HP:0040284). (ORPHA:101000)